- Dyslexia (HP:0010522): A learning disorder characterized primarily by difficulties in learning to read and spell. Dyslectic children also exhibit a tendency to read words from right to left and to confuse letters such as b and d whose orientation is important for their identification. Children with dyslexia appear to be impaired in phonemic skills (the ability to associate visual symbols with the sounds they represent). Evidence: IEA. (OMIM:608995)
- Non-Mendelian inheritance (HP:0001426): A mode of inheritance that depends on genetic determinants in more than one gene. Evidence: IEA. (OMIM:608995)
- Autosomal dominant inheritance (HP:0000006): A mode of inheritance that is observed for traits related to a gene encoded on one of the autosomes (i.e., the human chromosomes 1-22) in which a trait manifests in heterozygotes. In the context of medical genetics, an autosomal dominant disorder is caused when a single copy of the mutant allele is present. Males and females are affected equally, and can both transmit the disorder with a risk of 50% for each child of inheriting the mutant allele. Evidence: IEA. (OMIM:608995)
These phenotypes are associated with the disease dyslexia, susceptibility to, 8 (OMIM:608995).